- Abnormality of the skeletal system (HP:0000924): An abnormality of the skeletal system. Evidence: IEA. (OMIM:178350)
- Autosomal dominant inheritance (HP:0000006): A mode of inheritance that is observed for traits related to a gene encoded on one of the autosomes (i.e., the human chromosomes 1-22) in which a trait manifests in heterozygotes. In the context of medical genetics, an autosomal dominant disorder is caused when a single copy of the mutant allele is present. Males and females are affected equally, and can both transmit the disorder with a risk of 50% for each child of inheriting the mutant allele. Evidence: IEA. (OMIM:178350)
These phenotypes are associated with the disease pubic bone dysplasia (OMIM:178350).